- Hemiplegia (HP:0002301): Paralysis (complete loss of muscle function) in the arm, leg, and in some cases the face on one side of the body. Evidence: TAS. (OMIM:614820)
- Status epilepticus (HP:0002133): Status epilepticus is a type of prolonged seizure resulting either from the failure of the mechanisms responsible for seizure termination or from the initiation of mechanisms which lead to abnormally prolonged seizures (after time point t1). It is a condition that can have long-term consequences (after time point t2), including neuronal death, neuronal injury, and alteration of neuronal networks, depending on the type and duration of seizures. Evidence: TAS. (OMIM:614820)
- Abnormality of eye movement (HP:0000496): An abnormality in voluntary or involuntary eye movements or their control. Evidence: TAS. (OMIM:614820)
- Choreoathetosis (HP:0001266): Involuntary movements characterized by both athetosis (inability to sustain muscles in a fixed position) and chorea (widespread jerky arrhythmic movements). Evidence: TAS. (OMIM:614820)
- Dystonia (HP:0001332): An abnormally increased muscular tone that causes fixed abnormal postures. There is a slow, intermittent twisting motion that leads to exaggerated turning and posture of the extremities and trunk. Evidence: TAS. (OMIM:614820)
- Seizure (HP:0001250): A seizure is an intermittent abnormality of nervous system physiology characterized by a transient occurrence of signs and/or symptoms due to abnormal excessive or synchronous neuronal activity in the brain. Evidence: TAS. (OMIM:614820)
- Dysarthria (HP:0001260): Dysarthric speech is a general description referring to a neurological speech disorder characterized by poor articulation. Depending on the involved neurological structures, dysarthria may be further classified as spastic, flaccid, ataxic, hyperkinetic and hypokinetic, or mixed. Evidence: TAS. (OMIM:614820)
- Global developmental delay (HP:0001263): A delay in the achievement of motor or mental milestones in the domains of development of a child, including motor skills, speech and language, cognitive skills, and social and emotional skills. This term should only be used to describe children younger than five years of age. Evidence: TAS. (OMIM:614820)
- Ataxia (HP:0001251): Ataxia refers to impaired coordination of voluntary muscle movement. Cerebellar ataxia refers to ataxia due to dysfunction of the cerebellum. This causes a variety of elementary neurological deficits including asynergy (lack of coordination between muscles, limbs and joints), dysmetria (lack of ability to judge distances that can lead to under- or overshoot in grasping movements), and dysdiadochokinesia (inability to perform rapid movements requiring antagonizing muscle groups to be switched on and off repeatedly). Evidence: TAS. (OMIM:614820)
- Episodic quadriplegia (HP:0200072): Intermittent episodes of paralysis of all four limbs. Evidence: TAS. (OMIM:614820)
- Nystagmus (HP:0000639): Rhythmic, involuntary oscillations of one or both eyes related to abnormality in fixation, conjugate gaze, or vestibular mechanisms. Evidence: TAS. (OMIM:614820)
- Mental deterioration (HP:0001268): Loss of previously present mental abilities, generally in adults. Evidence: TAS. (OMIM:614820)
- Autosomal dominant inheritance (HP:0000006): A mode of inheritance that is observed for traits related to a gene encoded on one of the autosomes (i.e., the human chromosomes 1-22) in which a trait manifests in heterozygotes. In the context of medical genetics, an autosomal dominant disorder is caused when a single copy of the mutant allele is present. Males and females are affected equally, and can both transmit the disorder with a risk of 50% for each child of inheriting the mutant allele. Evidence: TAS. (OMIM:614820)
- Tetraplegia (HP:0002445): Paralysis of all four limbs, and trunk of the body below the level of an associated injury to the spinal cord. The etiology of quadriplegia is similar to that of paraplegia except that the lesion is in the cervical spinal cord rather than in the thoracic or lumbar segments of the spinal cord. Evidence: TAS. (OMIM:614820)
- Intellectual disability (HP:0001249): The term intellectual disability or intellectual developmental disorder is used to describe significantly sub-average intellectual and adaptive functioning based on clinical assessment and as measured by individually administered, appropriately normed, standardized and validated tests of intellectual functioning and adaptive behavior, with onset during the developmental period from infancy through adolescence. Evidence: TAS. (OMIM:614820)
These phenotypes are associated with the disease alternating hemiplegia of childhood 2 (OMIM:614820).